Phenotypes associated with the disease retinitis pigmentosa 67 (OMIM:615565):
- Autosomal recessive inheritance (HP:0000007): A mode of inheritance that is observed for traits related to a gene encoded on one of the autosomes (i.e., the human chromosomes 1-22) in which a trait manifests in individuals with two pathogenic alleles, either homozygotes (two copies of the same mutant allele) or compound heterozygotes (whereby each copy of a gene has a distinct mutant allele). Evidence: PCS. (PMID:24043777)
- Rod-cone dystrophy (HP:0000510): An inherited retinal disease subtype in which the rod photoreceptors appear to be more severely affected than the cone photoreceptors. Typical presentation is with nyctalopia (due to rod dysfunction) followed by loss of mid-peripheral field of vision, which gradually extends and leaves many patients with a small central island of vision due to the preservation of macular cones. Evidence: PCS. Frequency: 1/1. (PMID:24043777)